Phenotypes associated with the disease frontoocular syndrome (OMIM:605321):
- Epicanthus (HP:0000286): A fold of skin starting above the medial aspect of the upper eyelid and arching downward to cover, pass in front of and lateral to the medial canthus. Evidence: IEA. (OMIM:605321)
- Upslanted palpebral fissure (HP:0000582): The palpebral fissure inclination is more than two standard deviations above the mean for age (objective); or, the inclination of the palpebral fissure is greater than typical for age. Evidence: IEA. (OMIM:605321)
- Strabismus (HP:0000486): A misalignment of the eyes so that the visual axes deviate from bifoveal fixation. The classification of strabismus may be based on a number of features including the relative position of the eyes, whether the deviation is latent or manifest, intermittent or constant, concomitant or otherwise and according to the age of onset and the relevance of any associated refractive error. Evidence: IEA. (OMIM:605321)
- Mild intellectual disability (HP:0001256): Mild intellectual disability (ID) is defined as a type of ID characterized by mildly sub-average adaptive functioning and intellectual functioning, with an intelligence quotient (IQ) the range of 50-69. Evidence: IEA. (OMIM:605321)
- Trigonocephaly (HP:0000243): Wedge-shaped, or triangular head, with the apex of the triangle at the midline of the forehead and the base of the triangle at the occiput. Evidence: IEA. (OMIM:605321)
- Nevus flammeus (HP:0001052): A congenital vascular malformation consisting of superficial and deep dilated capillaries in the skin which produce a reddish to purplish discolouration of the skin. Evidence: IEA. (OMIM:605321)
- Narrow mouth (HP:0000160): Distance between the commissures of the mouth more than 2 SD below the mean. Alternatively, an apparently decreased width of the oral aperture (subjective). Evidence: IEA. (OMIM:605321)
- Blepharophimosis (HP:0000581): A fixed reduction in the vertical distance between the upper and lower eyelids with short palpebral fissures. Evidence: IEA. (OMIM:605321)
- Glabellar hemangioma (HP:0001076). Evidence: IEA. (OMIM:605321)
- Coronal craniosynostosis (HP:0004440): Premature closure of the coronal suture of skull. Evidence: TAS. (OMIM:605321)
- Short palpebral fissure (HP:0012745): Distance between the medial and lateral canthi is more than 2 SD below the mean for age (objective); or, apparently reduced length of the palpebral fissures. Evidence: TAS. (OMIM:605321)
- High palate (HP:0000218): Height of the palate more than 2 SD above the mean (objective) or palatal height at the level of the first permanent molar more than twice the height of the teeth (subjective). Evidence: IEA. (OMIM:605321)
- Pulmonic stenosis (HP:0001642): A narrowing of the right ventricular outflow tract that can occur at the pulmonary valve (valvular stenosis), below the pulmonary valve (infundibular stenosis), or above the pulmonary valve (supravalvar stenosis). Evidence: IEA. (OMIM:605321)
- Posteriorly rotated ears (HP:0000358): A type of abnormal location of the ears in which the position of the ears is characterized by posterior rotation (the superior part of the ears is rotated towards the back of the head, and the inferior part of the ears towards the front). Evidence: IEA. (OMIM:605321)
- Capillary hemangioma (HP:0005306): The presence of a capillary hemangioma, which are hemangiomas with small endothelial spaces. Evidence: IEA. (OMIM:605321)
- Narrow philtrum (HP:0011829): Distance between the philtral ridges, measured just above the vermilion border, more than 2 standard deviations below the mean. Alternatively, an apparently decreased distance between the ridges of the philtrum. Evidence: TAS. (OMIM:605321)
- Global developmental delay (HP:0001263): A delay in the achievement of motor or mental milestones in the domains of development of a child, including motor skills, speech and language, cognitive skills, and social and emotional skills. This term should only be used to describe children younger than five years of age. Evidence: IEA. (OMIM:605321)
- Inverted nipples (HP:0003186): The presence of nipples that instead of pointing outward are retracted inwards. Evidence: IEA. (OMIM:605321)
- Underdeveloped supraorbital ridges (HP:0009891): Flatness of the supraorbital portion of the frontal bones. Evidence: IEA. (OMIM:605321)
- Ptosis (HP:0000508): The upper eyelid margin is positioned 3 mm or more lower than usual and covers the superior portion of the iris (objective); or, the upper lid margin obscures at least part of the pupil (subjective). Evidence: IEA. (OMIM:605321)
- Prominent nasal bridge (HP:0000426): Anterior positioning of the nasal root in comparison to the usual positioning for age. Evidence: IEA. (OMIM:605321)
- Pectus excavatum (HP:0000767): A defect of the chest wall characterized by a depression of the sternum, giving the chest ("pectus") a caved-in ("excavatum") appearance. Evidence: IEA. (OMIM:605321)
- Hypotelorism (HP:0000601): Interpupillary distance less than 2 SD below the mean (alternatively, the appearance of an decreased interpupillary distance or closely spaced eyes). Evidence: IEA. (OMIM:605321)
- Proptosis (HP:0000520): An eye that is protruding anterior to the plane of the face to a greater extent than is typical. Evidence: IEA. (OMIM:605321)
- Atrial septal defect (HP:0001631): Atrial septal defect (ASD) is a congenital abnormality of the interatrial septum that enables blood flow between the left and right atria via the interatrial septum. Evidence: IEA. (OMIM:605321)
- Autosomal dominant inheritance (HP:0000006): A mode of inheritance that is observed for traits related to a gene encoded on one of the autosomes (i.e., the human chromosomes 1-22) in which a trait manifests in heterozygotes. In the context of medical genetics, an autosomal dominant disorder is caused when a single copy of the mutant allele is present. Males and females are affected equally, and can both transmit the disorder with a risk of 50% for each child of inheriting the mutant allele. Evidence: IEA. (OMIM:605321)
- Micrognathia (HP:0000347): Developmental hypoplasia of the mandible. Evidence: IEA. (OMIM:605321)
- Low-set ears (HP:0000369): Upper insertion of the ear to the scalp below an imaginary horizontal line drawn between the inner canthi of the eye and extending posteriorly to the ear. Evidence: IEA. (OMIM:605321)
- Myopia (HP:0000545): An abnormality of refraction characterized by the ability to see objects nearby clearly, while objects in the distance appear blurry. Evidence: IEA. (OMIM:605321)